Phenotypes associated with the disease X-linked epilepsy-learning disabilities-behavior disorders syndrome (ORPHA:85294):
- Macrocephaly (HP:0000256): Occipitofrontal (head) circumference greater than 97th centile compared to appropriate, age matched, sex-matched normal standards. Alternatively, a apparently increased size of the cranium. Evidence: TAS. Frequency: Very frequent (HP:0040281). (ORPHA:85294)
- Aggressive behavior (HP:0000718): Behavior or an act aimed at harming a person, animal, or physical property (e.g., acts of physical violence; shouting, swearing, and using harsh language; slashing someone's tires). Evidence: TAS. Frequency: Very frequent (HP:0040281). (ORPHA:85294)
- Seizure (HP:0001250): A seizure is an intermittent abnormality of nervous system physiology characterized by a transient occurrence of signs and/or symptoms due to abnormal excessive or synchronous neuronal activity in the brain. Evidence: TAS. Frequency: Very frequent (HP:0040281). (ORPHA:85294)
- Specific learning disability (HP:0001328): Impairment of certain skills such as reading or writing, coordination, self-control, or attention that interfere with the ability to learn. The impairment is not related to a global deficiency of intelligence. Evidence: TAS. Frequency: Very frequent (HP:0040281). (ORPHA:85294)